- Irregularly shaped sperm tail (HP:0033393): Irregular or changing caliber (diameter) along the tail of the sperm. Evidence: PCS. Frequency: 4/4. (PMID:30137358)
- Coiled sperm flagella (HP:0032560): Sperm cells whose flagella are twisted (coiled). Evidence: PCS. Frequency: 4/4. (PMID:30137358)
- Young adult onset (HP:0011462): Onset of disease at the age of between 16 and 40 years. Evidence: PCS. Frequency: 4/4. (PMID:30137358)
- Male infertility (HP:0003251). Evidence: PCS. Frequency: 4/4. (PMID:30137358)
- Autosomal recessive inheritance (HP:0000007): A mode of inheritance that is observed for traits related to a gene encoded on one of the autosomes (i.e., the human chromosomes 1-22) in which a trait manifests in individuals with two pathogenic alleles, either homozygotes (two copies of the same mutant allele) or compound heterozygotes (whereby each copy of a gene has a distinct mutant allele). Evidence: PCS. (PMID:30137358)
- Reduced sperm motility (HP:0012207): An abnormal reduction in the mobility of ejaculated sperm. Evidence: PCS. Frequency: 4/4. (PMID:30137358)
- Absent sperm axoneme central pair complex (HP:0033525): Absence of the central pair of microtubules in the sperm axoneme, thereby forming a 9+0 pattern instead of the normal 9+2 pattern. Evidence: PCS. Frequency: 1/1. (PMID:30137358)
- Absent sperm flagella (HP:0032558): Sperm cells lacking flagella. Evidence: PCS. Frequency: 4/4. (PMID:30137358)
- Short sperm flagella (HP:0032559): Sperm cells with abnormally short flagella. Evidence: PCS. Frequency: 4/4. (PMID:30137358)
These phenotypes are associated with the disease spermatogenic failure 34 (OMIM:618153).